Phenotypes associated with the disease myopia 2, autosomal dominant (OMIM:160700):
- Retinal detachment (HP:0000541): Separation of the inner layers of the retina (neural retina) from the pigment epithelium. Evidence: IEA. (OMIM:160700)
- Abnormality of the nervous system (HP:0000707): An abnormality of the nervous system. Evidence: IEA. (OMIM:160700)
- High myopia (HP:0011003): A severe form of myopia with greater than -6.00 diopters. Evidence: IEA. (OMIM:160700)
- Autosomal dominant inheritance (HP:0000006): A mode of inheritance that is observed for traits related to a gene encoded on one of the autosomes (i.e., the human chromosomes 1-22) in which a trait manifests in heterozygotes. In the context of medical genetics, an autosomal dominant disorder is caused when a single copy of the mutant allele is present. Males and females are affected equally, and can both transmit the disorder with a risk of 50% for each child of inheriting the mutant allele. Evidence: TAS. (OMIM:160700)